Phenotypes associated with the disease familial temporal lobe epilepsy 6 (OMIM:615697):
- Status epilepticus (HP:0002133): Status epilepticus is a type of prolonged seizure resulting either from the failure of the mechanisms responsible for seizure termination or from the initiation of mechanisms which lead to abnormally prolonged seizures (after time point t1). It is a condition that can have long-term consequences (after time point t2), including neuronal death, neuronal injury, and alteration of neuronal networks, depending on the type and duration of seizures. Evidence: PCS. Frequency: 2/11. (PMID:24021842)
- Febrile seizure (within the age range of 3 months to 6 years) (HP:0002373): A febrile seizure is any type of seizure (most often a generalized tonic-clonic seizure) occurring with fever (at least 38 degrees Celsius) but in the absence of central nervous system infection, severe metabolic disturbance or other alternative precipitant in children between the ages of 3 months and 6 years. Evidence: PCS. Frequency: 4/11. (PMID:24021842)
- Focal impaired awareness seizure (HP:0002384): Focal impaired awareness seizure (or focal seizure with impaired or lost awareness) is a type of focal-onset seizure characterized by some degree (which may be partial) of impairment of the person's awareness of themselves or their surroundings at any point during the seizure. Evidence: PCS. Frequency: 5/11. (PMID:24021842)
- Bilateral tonic-clonic seizure with focal onset (HP:0007334): A bilateral tonic-clonic seizure with focal onset is a focal-onset seizure which progresses into a bilateral tonic-clonic phase. Evidence: PCS. Frequency: 4/11. (PMID:24021842)
- Focal aware seizure (HP:0002349): A type of focal-onset seizure in which awareness is preserved. Awareness during a seizure is defined as the patient being fully aware of themself and their environment throughout the seizure, even if immobile. Evidence: PCS. Frequency: 4/11. (PMID:24021842)
- Autosomal dominant inheritance (HP:0000006): A mode of inheritance that is observed for traits related to a gene encoded on one of the autosomes (i.e., the human chromosomes 1-22) in which a trait manifests in heterozygotes. In the context of medical genetics, an autosomal dominant disorder is caused when a single copy of the mutant allele is present. Males and females are affected equally, and can both transmit the disorder with a risk of 50% for each child of inheriting the mutant allele. Evidence: PCS. (PMID:24021842)